- Microcephaly (HP:0000252): Head circumference below 2 standard deviations below the mean for age and gender. Evidence: PCS. Frequency: 2/2. (PMID:24748105)
- Sloping forehead (HP:0000340): Inclination of the anterior surface of the forehead from the vertical more than two standard deviations above the mean (objective); or apparently excessive posterior sloping of the forehead in a lateral view. Evidence: PCS. Frequency: 2/2. (PMID:24748105)
- Short foot (HP:0001773): A measured foot length that is more than 2 SD below the mean for a newborn of 27 - 41 weeks gestation, or foot that is less than the 3rd centile for individuals from birth to 16 years of age (objective). Alternatively, a foot that appears disproportionately short (subjective). Evidence: PCS. Frequency: 2/2. (PMID:24748105)
- Cerebellar hypoplasia (HP:0001321): Cerebellar hypoplasia is a descriptive term implying a cerebellum with a reduced volume, but a normal shape and is stable over time. Evidence: PCS. Frequency: 1/2. (PMID:24748105)
- Short stature (HP:0004322): A height below that which is expected according to age and gender norms. Although there is no universally accepted definition of short stature, many refer to "short stature" as height more than 2 standard deviations below the mean for age and gender (or below the 3rd percentile for age and gender dependent norms). Evidence: PCS. Frequency: 2/2. (PMID:24748105)
- Global developmental delay (HP:0001263): A delay in the achievement of motor or mental milestones in the domains of development of a child, including motor skills, speech and language, cognitive skills, and social and emotional skills. This term should only be used to describe children younger than five years of age. Evidence: PCS. Frequency: 2/2. (PMID:24748105)
- Nystagmus (HP:0000639): Rhythmic, involuntary oscillations of one or both eyes related to abnormality in fixation, conjugate gaze, or vestibular mechanisms. Evidence: PCS. Frequency: 1/2. (PMID:24748105)
- Subglottic stenosis (HP:0001607). Evidence: PCS. Frequency: 1/2. (PMID:24748105)
- Small for gestational age (HP:0001518): Smaller than normal size according to sex and gestational age related norms, defined as a weight below the 10th percentile for the gestational age. Evidence: PCS. Frequency: 2/2. (PMID:24748105)
- Primary microcephaly (HP:0011451): Head circumference below 2 standard deviations below the mean for age and gender at birth. Evidence: PCS. Frequency: 1/1. (PMID:24748105)
- Tonic seizure (HP:0032792): A tonic seizure is a type of motor seizure characterized by unilateral or bilateral limb stiffening or elevation, often with neck stiffening. Evidence: PCS. Frequency: 1/2. Onset: Infantile onset (HP:0003593). (PMID:24748105)
- Fetal onset (HP:0011461): Onset prior to birth but after 8 weeks of embryonic development (corresponding to a gestational age of 10 weeks). Evidence: PCS. Frequency: 2/2. (PMID:24748105)
- Prominent nose (HP:0000448): Distance between subnasale and pronasale more than two standard deviations above the mean, or alternatively, an apparently increased anterior protrusion of the nasal tip. Evidence: PCS. Frequency: 1/2. (PMID:24748105)
- Autosomal recessive inheritance (HP:0000007): A mode of inheritance that is observed for traits related to a gene encoded on one of the autosomes (i.e., the human chromosomes 1-22) in which a trait manifests in individuals with two pathogenic alleles, either homozygotes (two copies of the same mutant allele) or compound heterozygotes (whereby each copy of a gene has a distinct mutant allele). Evidence: PCS. (PMID:24748105)
- Partial agenesis of the corpus callosum (HP:0001338): A partial failure of the development of the corpus callosum. Evidence: PCS. Frequency: 1/2. (PMID:24748105)
- Restrictive cardiomyopathy (HP:0001723): Restrictive left ventricular physiology is characterized by a pattern of ventricular filling in which increased stiffness of the myocardium causes ventricular pressure to rise precipitously with only small increases in volume, defined as restrictive ventricular physiology in the presence of normal or reduced diastolic volumes (of one or both ventricles), normal or reduced systolic volumes, and normal ventricular wall thickness. Evidence: PCS. Frequency: 1/2. Onset: Congenital onset (HP:0003577). (PMID:24748105)
- Metaphyseal sclerosis (HP:0004979): Abnormally increased density of metaphyseal bone. Evidence: PCS. Frequency: 1/2. Onset: Congenital onset (HP:0003577). (PMID:24748105)
- Intrauterine growth retardation (HP:0001511): An abnormal restriction of fetal growth with fetal weight below the tenth percentile for gestational age. Evidence: PCS. Frequency: 2/2. (PMID:24748105)
- Small hand (HP:0200055): Disproportionately small hand. Evidence: PCS. Frequency: 2/2. (PMID:24748105)
- Macrotia (HP:0000400): Median longitudinal ear length greater than two standard deviations above the mean and median ear width greater than two standard deviations above the mean (objective); or, apparent increase in length and width of the pinna (subjective). Evidence: PCS. Frequency: 1/2. (PMID:24748105)
- Round face (HP:0000311): The facial appearance is more circular than usual as viewed from the front. Evidence: PCS. Frequency: 1/2. (PMID:24748105)
- Micrognathia (HP:0000347): Developmental hypoplasia of the mandible. Evidence: PCS. Frequency: 1/2. Onset: Infantile onset (HP:0003593). (PMID:24748105)
- Simplified gyral pattern (HP:0009879): An abnormality of the cerebral cortex with fewer gyri but with normal cortical thickness. This pattern is usually often associated with congenital microcephaly. Evidence: PCS. Frequency: 1/2. (PMID:24748105)
These phenotypes are associated with the disease microcephaly 13, primary, autosomal recessive (OMIM:616051).